- Autosomal recessive inheritance (HP:0000007): A mode of inheritance that is observed for traits related to a gene encoded on one of the autosomes (i.e., the human chromosomes 1-22) in which a trait manifests in individuals with two pathogenic alleles, either homozygotes (two copies of the same mutant allele) or compound heterozygotes (whereby each copy of a gene has a distinct mutant allele). Evidence: IEA. (OMIM:234820)
- Abnormality of the cardiovascular system (HP:0001626): Any abnormality of the cardiovascular system. Evidence: IEA. (OMIM:234820)
These phenotypes are associated with the disease hemangiopericytoma, malignant (OMIM:234820).